- Hearing impairment (HP:0000365): A decreased magnitude of the sensory perception of sound. Evidence: IEA. (OMIM:178651)
- Ventricular hypertrophy (HP:0001714): Enlargement of the cardiac ventricular muscle tissue with increase in the width of the wall of the ventricle and loss of elasticity. Ventricular hypertrophy is clinically differentiated into left and right ventricular hypertrophy. Evidence: TAS. (OMIM:178651)
- Pulmonic stenosis (HP:0001642): A narrowing of the right ventricular outflow tract that can occur at the pulmonary valve (valvular stenosis), below the pulmonary valve (infundibular stenosis), or above the pulmonary valve (supravalvar stenosis). Evidence: TAS. (OMIM:178651)
- Autosomal dominant inheritance (HP:0000006): A mode of inheritance that is observed for traits related to a gene encoded on one of the autosomes (i.e., the human chromosomes 1-22) in which a trait manifests in heterozygotes. In the context of medical genetics, an autosomal dominant disorder is caused when a single copy of the mutant allele is present. Males and females are affected equally, and can both transmit the disorder with a risk of 50% for each child of inheriting the mutant allele. Evidence: IEA. (OMIM:178651)
These phenotypes are associated with the disease pulmonic stenosis and deafness (OMIM:178651).